- Impaired vibration sensation in the lower limbs (HP:0002166): A decrease in the ability to perceive vibration in the legs. Evidence: IEA. (OMIM:607565)
- Urinary urgency (HP:0000012): Urge incontinence is the strong, sudden need to urinate. Evidence: IEA. (OMIM:607565)
- Abnormality of eye movement (HP:0000496): An abnormality in voluntary or involuntary eye movements or their control. Evidence: IEA. (OMIM:607565)
- Dystonia (HP:0001332): An abnormally increased muscular tone that causes fixed abnormal postures. There is a slow, intermittent twisting motion that leads to exaggerated turning and posture of the extremities and trunk. Evidence: IEA. (OMIM:607565)
- Babinski sign (HP:0003487): Upturning of the big toe (and sometimes fanning of the other toes) in response to stimulation of the sole of the foot. If the Babinski sign is present it can indicate damage to the corticospinal tract. Evidence: IEA. (OMIM:607565)
- Cerebellar atrophy (HP:0001272): Cerebellar atrophy is defined as a cerebellum with initially normal structures, in a posterior fossa with normal size, which displays enlarged fissures (interfolial spaces) in comparison to the foliae secondary to loss of tissue. Cerebellar atrophy implies irreversible loss of tissue and result from an ongoing progressive disease until a final stage is reached or a single injury, e.g. an intoxication or infectious event. Evidence: IEA. (OMIM:607565)
- Dysarthria (HP:0001260): Dysarthric speech is a general description referring to a neurological speech disorder characterized by poor articulation. Depending on the involved neurological structures, dysarthria may be further classified as spastic, flaccid, ataxic, hyperkinetic and hypokinetic, or mixed. Evidence: IEA. (OMIM:607565)
- Urinary incontinence (HP:0000020): Loss of the ability to control the urinary bladder leading to involuntary urination. Evidence: IEA. (OMIM:607565)
- Ataxia (HP:0001251): Ataxia refers to impaired coordination of voluntary muscle movement. Cerebellar ataxia refers to ataxia due to dysfunction of the cerebellum. This causes a variety of elementary neurological deficits including asynergy (lack of coordination between muscles, limbs and joints), dysmetria (lack of ability to judge distances that can lead to under- or overshoot in grasping movements), and dysdiadochokinesia (inability to perform rapid movements requiring antagonizing muscle groups to be switched on and off repeatedly). Evidence: IEA. (OMIM:607565)
- Spastic gait (HP:0002064): Spasticity is manifested by increased stretch reflex which is intensified with movement velocity. This results in excessive and inappropriate muscle activation which can contribute to muscle hypertonia. Spastic gait is characterized by manifestations such as muscle hypertonia, stiff knee, and circumduction of the leg. Evidence: IEA. (OMIM:607565)
- Lower limb spasticity (HP:0002061): Spasticity (velocity-dependent increase in tonic stretch reflexes with increased muscle tone and hyperexcitable tendon reflexes) in the muscles of the lower limbs, hips, and pelvis. Evidence: IEA. (OMIM:607565)
- Knee clonus (HP:0011449): Clonus is an involuntary tendon reflex that causes repeated flexion and extension of the foot. Knee clonus can be tested by rapidly pushing the patella towards the toes. Evidence: TAS. (OMIM:607565)
- Ankle clonus (HP:0011448): Clonus is an involuntary tendon reflex that causes repeated flexion and extension of the foot. Ankle clonus is tested by rapidly flexing the foot upward. Evidence: TAS. (OMIM:607565)
- Lower limb muscle weakness (HP:0007340): Weakness of the muscles of the legs. Evidence: IEA. (OMIM:607565)
- Urinary bladder sphincter dysfunction (HP:0002839): Abnormal function of a sphincter of the urinary bladder. Evidence: IEA. (OMIM:607565)
- Spastic paraplegia (HP:0001258): Complete loss of the ability to move the lower limbs accompanied by spasticity of the lower limbs. Evidence: IEA. (OMIM:607565)
- Autosomal dominant inheritance (HP:0000006): A mode of inheritance that is observed for traits related to a gene encoded on one of the autosomes (i.e., the human chromosomes 1-22) in which a trait manifests in heterozygotes. In the context of medical genetics, an autosomal dominant disorder is caused when a single copy of the mutant allele is present. Males and females are affected equally, and can both transmit the disorder with a risk of 50% for each child of inheriting the mutant allele. Evidence: IEA. (OMIM:607565)
- Intellectual disability (HP:0001249): The term intellectual disability or intellectual developmental disorder is used to describe significantly sub-average intellectual and adaptive functioning based on clinical assessment and as measured by individually administered, appropriately normed, standardized and validated tests of intellectual functioning and adaptive behavior, with onset during the developmental period from infancy through adolescence. Evidence: IEA. (OMIM:607565)
- Hyperreflexia (HP:0001347): Hyperreflexia is the presence of hyperactive stretch reflexes of the muscles. Evidence: IEA. (OMIM:607565)
These phenotypes are associated with the disease spastic paraplegia, ataxia, and intellectual disability (OMIM:607565).